- Abnormality of the cardiovascular system (HP:0001626): Any abnormality of the cardiovascular system. Evidence: IEA. (OMIM:108000)
- Autosomal dominant inheritance (HP:0000006): A mode of inheritance that is observed for traits related to a gene encoded on one of the autosomes (i.e., the human chromosomes 1-22) in which a trait manifests in heterozygotes. In the context of medical genetics, an autosomal dominant disorder is caused when a single copy of the mutant allele is present. Males and females are affected equally, and can both transmit the disorder with a risk of 50% for each child of inheriting the mutant allele. Evidence: IEA. (OMIM:108000)
These phenotypes are associated with the disease arteries, anomalies of (OMIM:108000).